- Mild postnatal growth retardation (HP:0001530): A mild degree of slow or limited growth after birth, being between two and three standard deviations below age- and sex-related norms. Evidence: PCS. (PMID:21396577)
- Decreased circulating insulin-like growth factor 1 concentration (HP:0030353): The concentration of insulin-like growth factor 1 (IGF1) in the blood circulation is below the lower limit of normal. Evidence: PCS. (PMID:21396577)
- Insulin insensitivity (HP:0008189): Decreased sensitivity toward insulin. Evidence: PCS. (PMID:21396577)
- Decreased circulating insulin-like growth factor-binding protein acid labile subunit concentration (HP:0045046): The concentration of insulin-like growth factor-binding protein acid labile subunit in the blood circulation is below the lower limit of normal. Evidence: PCS. Frequency: 1/1. (PMID:14762184)
- Delayed puberty (HP:0000823): Passing the age when puberty normally occurs with no physical or hormonal signs of the onset of puberty. Evidence: PCS. (PMID:21396577)
These phenotypes are associated with the disease short stature due to primary acid-labile subunit deficiency (OMIM:615961).